- Abnormal large intestine morphology (HP:0002250): Any abnormality of the large intestine. Evidence: IEA. (OMIM:107700)
This phenotype is associated with the disease appendicitis, proneness to (OMIM:107700).